Phenotypes associated with the disease cystic hygroma (OMIM:257350):
- Stillbirth (HP:0003826): Death of the fetus in utero after at least 22 weeks of gestation. Evidence: TAS. (OMIM:257350)
- Autosomal recessive inheritance (HP:0000007): A mode of inheritance that is observed for traits related to a gene encoded on one of the autosomes (i.e., the human chromosomes 1-22) in which a trait manifests in individuals with two pathogenic alleles, either homozygotes (two copies of the same mutant allele) or compound heterozygotes (whereby each copy of a gene has a distinct mutant allele). Evidence: TAS. (OMIM:257350)
- Hydrops fetalis (HP:0001789): The abnormal accumulation of fluid in two or more fetal compartments, including ascites, pleural effusion, pericardial effusion, and skin edema. Evidence: TAS. (OMIM:257350)
- Fetal cystic hygroma (HP:0010878): The presence during the prenatal period of a cystic mass with multiple septa with multiple, asymmetric, thin-walled cysts near the posterior aspect of the neck. Fetal cystic hygroma can be defined as nuchal translucency with or without septations measuring greater than 3.0 mm. Increased NT refers to a measurement above the 95th centile, and the term is used irrespective of whether the collection of fluid is septated or not, and whether it is confined to the neck or envelopes the whole fetus. After 14 weeks, increased NT usually resolves, but in some cases it evolves into nuchal edema or cystic hygromas. Evidence: TAS. (OMIM:257350)
- Cystic hygroma (HP:0000476): A cystic lymphatic lesion of the neck. Evidence: TAS. (OMIM:257350)